- Colon cancer (HP:0003003). Evidence: TAS. (OMIM:120435)
- Autosomal dominant inheritance (HP:0000006): A mode of inheritance that is observed for traits related to a gene encoded on one of the autosomes (i.e., the human chromosomes 1-22) in which a trait manifests in heterozygotes. In the context of medical genetics, an autosomal dominant disorder is caused when a single copy of the mutant allele is present. Males and females are affected equally, and can both transmit the disorder with a risk of 50% for each child of inheriting the mutant allele. Evidence: TAS. (OMIM:120435)
These phenotypes are associated with the disease Lynch syndrome 1 (OMIM:120435).